Phenotypes associated with the disease thyroid cancer, nonmedullary, 4 (OMIM:616534):
- Papillary thyroid carcinoma (HP:0002895): The presence of a papillary adenocarcinoma of the thyroid gland. Evidence: PCS. Frequency: 3/4. (PMID:25381600)
- Ovarian neoplasm (HP:0100615): A tumor (abnormal growth of tissue) of the ovary. Evidence: PCS. Frequency: 1/4. (PMID:25381600)
- Basal cell carcinoma (HP:0002671): The presence of a basal cell carcinoma of the skin. Evidence: PCS. Frequency: 1/4. (PMID:25381600)
- Prostate cancer (HP:0012125): A cancer of the prostate. Evidence: PCS. Frequency: 1/4. (PMID:25381600)
- Autosomal dominant inheritance (HP:0000006): A mode of inheritance that is observed for traits related to a gene encoded on one of the autosomes (i.e., the human chromosomes 1-22) in which a trait manifests in heterozygotes. In the context of medical genetics, an autosomal dominant disorder is caused when a single copy of the mutant allele is present. Males and females are affected equally, and can both transmit the disorder with a risk of 50% for each child of inheriting the mutant allele. Evidence: PCS. (PMID:25381600)
- Goiter (HP:0000853): An enlargement of the thyroid gland. Evidence: IEA. (OMIM:616534)